Phenotypes associated with the disease renal cell carcinoma, Xp11-associated (OMIM:300854):
- Typified by somatic mosaicism (HP:0001442): Description of conditions in which affected individuals typically display somatic mosaicism, i.e., genetically distinct populations of somatic cells in a given organism caused by DNA mutations, epigenetic alterations of DNA, chromosomal abnormalities or the spontaneous reversion of inherited mutations. In many conditions typified by somatic mosaicism, constitutive mutation is lethal and cases are exclusively or predominantly mosaic. Evidence: TAS. (OMIM:300854)
- Renal cell carcinoma (HP:0005584): A type of carcinoma of the kidney with origin in the epithelium of the proximal convoluted renal tubule. Evidence: TAS. (OMIM:300854)